Phenotypes associated with the disease Septo-optic dysplasia spectrum (ORPHA:3157):
- Visual impairment (HP:0000505): Visual impairment (or vision impairment) is vision loss (of a person) to such a degree as to qualify as an additional support need through a significant limitation of visual capability resulting from either disease, trauma, or congenital or degenerative conditions that cannot be corrected by conventional means, such as refractive correction, medication, or surgery. Evidence: TAS. Frequency: Very frequent (HP:0040281). (ORPHA:3157)
- Optic nerve hypoplasia (HP:0000609): Underdevelopment of the optic nerve. Evidence: TAS. Frequency: Very frequent (HP:0040281). (ORPHA:3157)
- Septo-optic dysplasia (HP:0100842): Underdevelopment of the optic nerve and absence of the septum pellucidum. Evidence: TAS. Frequency: Very frequent (HP:0040281). (ORPHA:3157)
- Cryptorchidism (HP:0000028): Testis in inguinal canal. That is, absence of one or both testes from the scrotum owing to failure of the testis or testes to descend through the inguinal canal to the scrotum. Evidence: TAS. Frequency: Frequent (HP:0040282). (ORPHA:3157)
- Cleft palate (HP:0000175): Cleft palate is a developmental defect of the palate resulting from a failure of fusion of the palatine processes and manifesting as a separation of the roof of the mouth (soft and hard palate). Evidence: TAS. Frequency: Frequent (HP:0040282). (ORPHA:3157)
- Strabismus (HP:0000486): A misalignment of the eyes so that the visual axes deviate from bifoveal fixation. The classification of strabismus may be based on a number of features including the relative position of the eyes, whether the deviation is latent or manifest, intermittent or constant, concomitant or otherwise and according to the age of onset and the relevance of any associated refractive error. Evidence: TAS. Frequency: Frequent (HP:0040282). (ORPHA:3157)
- Nystagmus (HP:0000639): Rhythmic, involuntary oscillations of one or both eyes related to abnormality in fixation, conjugate gaze, or vestibular mechanisms. Evidence: TAS. Frequency: Frequent (HP:0040282). (ORPHA:3157)
- Abnormality of the hypothalamus-pituitary axis (HP:0000864): Abnormality of the pituitary gland (also known as hypophysis), which is an endocrine gland that protrudes from the bottom of the hypothalamus at the base of the brain. The pituitary gland secretes the hormones ACTH, TSH, PRL, GH, endorphins, FSH, LH, oxytocin, and antidiuretic hormone. The secretion of hormones from the anterior pituitary is under the strict control of hypothalamic hormones, and the posterior pituitary is essentially an extension of the hypothalamus, so that hypothalamus and pituitary gland may be regarded as a functional unit. Evidence: TAS. Frequency: Frequent (HP:0040282). (ORPHA:3157)
- Seizure (HP:0001250): A seizure is an intermittent abnormality of nervous system physiology characterized by a transient occurrence of signs and/or symptoms due to abnormal excessive or synchronous neuronal activity in the brain. Evidence: TAS. Frequency: Frequent (HP:0040282). (ORPHA:3157)
- Agenesis of corpus callosum (HP:0001274): Absence of the corpus callosum as a result of the failure of the corpus callosum to develop, which can be the result of a failure in any one of the multiple steps of callosal development including cellular proliferation and migration, axonal growth or glial patterning at the midline. Evidence: TAS. Frequency: Frequent (HP:0040282). (ORPHA:3157)
- Absent septum pellucidum (HP:0001331): Absence of the septum pellucidum (meaning translucent wall in Latin - SP), also known as the ventricle of Sylvius. The septum pellucidum is a thin, triangular double membrane separating the frontal horns of the right and left lateral ventricles of the brain. It extends between the anterior portion of the corpus callosum, and the body of the fornix and its width varies from 1.5 to 3.0 mm. Evidence: TAS. Frequency: Frequent (HP:0040282). (ORPHA:3157)
- Short stature (HP:0004322): A height below that which is expected according to age and gender norms. Although there is no universally accepted definition of short stature, many refer to "short stature" as height more than 2 standard deviations below the mean for age and gender (or below the 3rd percentile for age and gender dependent norms). Evidence: TAS. Frequency: Frequent (HP:0040282). (ORPHA:3157)
- Hemiplegia/hemiparesis (HP:0004374): Loss of strength in the arm, leg, and sometimes face on one side of the body. Hemiplegia refers to a severe or complete loss of strength, whereas hemiparesis refers to a relatively mild loss of strength. Evidence: TAS. Frequency: Frequent (HP:0040282). (ORPHA:3157)
- Hypoplasia of penis (HP:0008736). Evidence: TAS. Frequency: Frequent (HP:0040282). (ORPHA:3157)
- Anterior pituitary hypoplasia (HP:0010627): Underdevelopment of the anterior pituitary gland. Evidence: TAS. Frequency: Frequent (HP:0040282). (ORPHA:3157)
- Sensorineural hearing impairment (HP:0000407): A type of hearing impairment in one or both ears related to an abnormal functionality of the cochlear nerve. Evidence: TAS. Frequency: Occasional (HP:0040283). (ORPHA:3157)
- Anosmia (HP:0000458): An inability to perceive odors. This is a general term describing inability to smell arising in any part of the process of smelling from absorption of odorants into the nasal mucous overlying the olfactory epithelium, diffusion to the cilia, binding to olfactory receptor sites, generation of action potentials in olfactory neurons, and perception of a smell. Evidence: TAS. Frequency: Occasional (HP:0040283). (ORPHA:3157)
- Autism (HP:0000717): Autism is a neurodevelopmental disorder characterized by impaired social interaction and communication, and by restricted and repetitive behavior. Autism begins in childhood. It is marked by the presence of markedly abnormal or impaired development in social interaction and communication and a markedly restricted repertoire of activity and interest. Manifestations of the disorder vary greatly depending on the developmental level and chronological age of the individual (DSM-IV). Evidence: TAS. Frequency: Occasional (HP:0040283). (ORPHA:3157)
- Diabetes insipidus (HP:0000873): A state of excessive water intake and hypotonic (dilute) polyuria. Diabetes insipidus may be due to failure of vasopressin (AVP) release (central or neurogenic diabetes insipidus) or to a failure of the kidney to respond to AVP (nephrogenic diabetes insipidus). Evidence: TAS. Frequency: Occasional (HP:0040283). (ORPHA:3157)
- Dry skin (HP:0000958): Skin characterized by the lack of natural or normal moisture. Evidence: TAS. Frequency: Occasional (HP:0040283). (ORPHA:3157)
- Hypohidrosis (HP:0000966): Abnormally diminished capacity to sweat. Evidence: TAS. Frequency: Occasional (HP:0040283). (ORPHA:3157)
- Intellectual disability (HP:0001249): The term intellectual disability or intellectual developmental disorder is used to describe significantly sub-average intellectual and adaptive functioning based on clinical assessment and as measured by individually administered, appropriately normed, standardized and validated tests of intellectual functioning and adaptive behavior, with onset during the developmental period from infancy through adolescence. Evidence: TAS. Frequency: Occasional (HP:0040283). (ORPHA:3157)
- Global developmental delay (HP:0001263): A delay in the achievement of motor or mental milestones in the domains of development of a child, including motor skills, speech and language, cognitive skills, and social and emotional skills. This term should only be used to describe children younger than five years of age. Evidence: TAS. Frequency: Occasional (HP:0040283). (ORPHA:3157)
- Obesity (HP:0001513): Accumulation of substantial excess body fat. Evidence: TAS. Frequency: Occasional (HP:0040283). (ORPHA:3157)
- Polydipsia (HP:0001959): Excessive thirst manifested by excessive fluid intake. Evidence: TAS. Frequency: Occasional (HP:0040283). (ORPHA:3157)
- Constipation (HP:0002019): Infrequent or difficult evacuation of feces. Evidence: TAS. Frequency: Occasional (HP:0040283). (ORPHA:3157)
- Esophageal atresia (HP:0002032): A developmental defect resulting in complete obliteration of the lumen of the esophagus such that the esophagus ends in a blind pouch rather than connecting to the stomach. Evidence: TAS. Frequency: Occasional (HP:0040283). (ORPHA:3157)
- Sleep disturbance (HP:0002360): An abnormal pattern in the quality, quantity, or characteristics of sleep. Evidence: TAS. Frequency: Occasional (HP:0040283). (ORPHA:3157)
- Tracheoesophageal fistula (HP:0002575): An abnormal connection (fistula) between the esophagus and the trachea. Evidence: TAS. Frequency: Occasional (HP:0040283). (ORPHA:3157)
- Aplasia/Hypoplasia of the cerebellum (HP:0007360). Evidence: TAS. Frequency: Occasional (HP:0040283). (ORPHA:3157)
- Maternal diabetes (HP:0009800): Maternal diabetes can either be a gestational, mostly type 2 diabetes, or a type 1 diabetes. Essential is the resulting maternal hyperglycemia as a non-specific teratogen, imposing the same risk of congenital malformations to pregnant women with both type 1 and type2 diabetes. Evidence: TAS. Frequency: Occasional (HP:0040283). (ORPHA:3157)
- Fatigue (HP:0012378): A subjective feeling of tiredness characterized by a lack of energy and motivation. Evidence: TAS. Frequency: Occasional (HP:0040283). (ORPHA:3157)
- Abnormal cardiovascular system morphology (HP:0030680): Any structural anomaly of the heart and blood vessels. Evidence: TAS. Frequency: Occasional (HP:0040283). (ORPHA:3157)